- Hyperactive patellar reflex (HP:0007083). Evidence: TAS. (OMIM:311050)
- Babinski sign (HP:0003487): Upturning of the big toe (and sometimes fanning of the other toes) in response to stimulation of the sole of the foot. If the Babinski sign is present it can indicate damage to the corticospinal tract. Evidence: TAS. (OMIM:311050)
- Dysarthria (HP:0001260): Dysarthric speech is a general description referring to a neurological speech disorder characterized by poor articulation. Depending on the involved neurological structures, dysarthria may be further classified as spastic, flaccid, ataxic, hyperkinetic and hypokinetic, or mixed. Evidence: TAS. (OMIM:311050)
- Dysdiadochokinesis (HP:0002075): A type of ataxia characterized by the impairment of the ability to perform rapidly alternating movements, such as pronating and supinating his or her hand on the dorsum of the other hand as rapidly as possible. Evidence: TAS. (OMIM:311050)
- Optic atrophy (HP:0000648): Atrophy of the optic nerve. Optic atrophy results from the death of the retinal ganglion cell axons that comprise the optic nerve and manifesting as a pale optic nerve on fundoscopy. Evidence: TAS. (OMIM:311050)
- X-linked inheritance (HP:0001417): A mode of inheritance that is observed for traits related to a gene encoded on the X chromosome. Evidence: TAS. (OMIM:311050)
- Absent Achilles reflex (HP:0003438): Absence of the Achilles reflex (also known as the ankle jerk reflex), which can normally be elicited by tapping the tendon is tapped while the foot is dorsiflexed. Evidence: TAS. (OMIM:311050)
- Intellectual disability (HP:0001249): The term intellectual disability or intellectual developmental disorder is used to describe significantly sub-average intellectual and adaptive functioning based on clinical assessment and as measured by individually administered, appropriately normed, standardized and validated tests of intellectual functioning and adaptive behavior, with onset during the developmental period from infancy through adolescence. Evidence: TAS. (OMIM:311050)
- Tremor (HP:0001337): An unintentional, oscillating to-and-fro muscle movement about a joint axis. Evidence: TAS. (OMIM:311050)
These phenotypes are associated with the disease optic atrophy 2 (OMIM:311050).